- Constriction of peripheral visual field (HP:0001133): An absolute or relative decrease in retinal sensitivity extending from edge (periphery) of the visual field in a concentric pattern. The visual field is the area that is perceived simultaneously by a fixating eye. Evidence: PCS. (PMID:20705278)
- Spicular pigmentation of the retina (HP:0007737): Pigment migration into the retina in a bone-spicule configuration (resembling the nucleated cells within the lacuna of bone). Evidence: PCS. (PMID:20705278)
- Nyctalopia (HP:0000662): Inability to see well at night or in poor light. Evidence: PCS. (PMID:20705278)
- Autosomal recessive inheritance (HP:0000007): A mode of inheritance that is observed for traits related to a gene encoded on one of the autosomes (i.e., the human chromosomes 1-22) in which a trait manifests in individuals with two pathogenic alleles, either homozygotes (two copies of the same mutant allele) or compound heterozygotes (whereby each copy of a gene has a distinct mutant allele). Evidence: PCS. (PMID:20705278)
- Rod-cone dystrophy (HP:0000510): An inherited retinal disease subtype in which the rod photoreceptors appear to be more severely affected than the cone photoreceptors. Typical presentation is with nyctalopia (due to rod dysfunction) followed by loss of mid-peripheral field of vision, which gradually extends and leaves many patients with a small central island of vision due to the preservation of macular cones. Evidence: PCS. (PMID:20705278)
- Optic disc pallor (HP:0000543): A pale yellow discoloration of the optic disc (the area of the optic nerve head in the retina). The optic disc normally has a pinkish hue with a central yellowish depression. Evidence: PCS. (PMID:20705278)
These phenotypes are associated with the disease retinitis pigmentosa 28 (OMIM:606068).